Phenotypes associated with the disease abdominal obesity-metabolic syndrome quantitative trait locus 2 (OMIM:605572):
- Hypertension (HP:0000822): The presence of chronic increased pressure in the systemic arterial system. Evidence: TAS. (OMIM:605572)
- Abdominal obesity (HP:0012743): Excessive fat around the stomach and abdomen. Evidence: TAS. (OMIM:605572)
- Autosomal dominant inheritance (HP:0000006): A mode of inheritance that is observed for traits related to a gene encoded on one of the autosomes (i.e., the human chromosomes 1-22) in which a trait manifests in heterozygotes. In the context of medical genetics, an autosomal dominant disorder is caused when a single copy of the mutant allele is present. Males and females are affected equally, and can both transmit the disorder with a risk of 50% for each child of inheriting the mutant allele. Evidence: TAS. (OMIM:605572)